Phenotypes associated with the disease Severe intellectual disability-progressive postnatal microcephaly-midline stereotypic hand movements syndrome (ORPHA:397933):
- Progressive microcephaly (HP:0000253): Progressive microcephaly is diagnosed when the head circumference falls progressively behind age- and gender-dependent norms. Evidence: TAS. Frequency: Frequent (HP:0040282). (ORPHA:397933)
- Atypical behavior (HP:0000708): Atypical behavior is an abnormality in a person's actions that can be controlled or modulated by the will of the individual. While abnormal behaviors can be difficult to control, they are distinct from other abnormal actions that cannot be affected by the individual's will. Evidence: TAS. Frequency: Frequent (HP:0040282). (ORPHA:397933)
- Seizure (HP:0001250): A seizure is an intermittent abnormality of nervous system physiology characterized by a transient occurrence of signs and/or symptoms due to abnormal excessive or synchronous neuronal activity in the brain. Evidence: TAS. Frequency: Frequent (HP:0040282). (ORPHA:397933)
- Hypotonia (HP:0001252): Hypotonia is an abnormally low muscle tone (the amount of tension or resistance to movement in a muscle). Even when relaxed, muscles have a continuous and passive partial contraction which provides some resistance to passive stretching. Hypotonia thus manifests as diminished resistance to passive stretching. Hypotonia is not the same as muscle weakness, although the two conditions can co-exist. Evidence: TAS. Frequency: Frequent (HP:0040282). (ORPHA:397933)
- Global developmental delay (HP:0001263): A delay in the achievement of motor or mental milestones in the domains of development of a child, including motor skills, speech and language, cognitive skills, and social and emotional skills. This term should only be used to describe children younger than five years of age. Evidence: TAS. Frequency: Frequent (HP:0040282). (ORPHA:397933)
- Developmental regression (HP:0002376): Loss of developmental skills, as manifested by loss of developmental milestones. Evidence: TAS. Frequency: Frequent (HP:0040282). (ORPHA:397933)
- Severe intellectual disability (HP:0010864): Severe intellectual disability (ID) is defined as a type of ID characterized by severely sub-average adaptive functioning and intellectual functioning, with an intelligence quotient (IQ) the range of 20-34. Evidence: TAS. Frequency: Frequent (HP:0040282). (ORPHA:397933)
- Stereotypical hand wringing (HP:0012171): Habitual clasping and wringing of the hands in the middle of the body, similar to a hand-washing movement. Evidence: TAS. Frequency: Frequent (HP:0040282). (ORPHA:397933)
- Reduced social responsiveness (HP:0012760): A reduced ability to participate in the back-and-forth flow of social interaction appropriate to culture and developmental level, which is normally characterized by an influence of the behavior of one person on the behavior of another person. This results in difficulty interacting with others through emotional, physical, or verbal communication. Evidence: TAS. Frequency: Frequent (HP:0040282). (ORPHA:397933)
- Micrognathia (HP:0000347): Developmental hypoplasia of the mandible. Evidence: TAS. Frequency: Occasional (HP:0040283). (ORPHA:397933)
- Macrotia (HP:0000400): Median longitudinal ear length greater than two standard deviations above the mean and median ear width greater than two standard deviations above the mean (objective); or, apparent increase in length and width of the pinna (subjective). Evidence: TAS. Frequency: Occasional (HP:0040283). (ORPHA:397933)
- Strabismus (HP:0000486): A misalignment of the eyes so that the visual axes deviate from bifoveal fixation. The classification of strabismus may be based on a number of features including the relative position of the eyes, whether the deviation is latent or manifest, intermittent or constant, concomitant or otherwise and according to the age of onset and the relevance of any associated refractive error. Evidence: TAS. Frequency: Occasional (HP:0040283). (ORPHA:397933)
- Horizontal nystagmus (HP:0000666): Nystagmus consisting of horizontal to-and-fro eye movements. Evidence: TAS. Frequency: Occasional (HP:0040283). (ORPHA:397933)
- Absent speech (HP:0001344): Complete lack of development of speech and language abilities. Evidence: TAS. Frequency: Occasional (HP:0040283). (ORPHA:397933)
- Hyperkinetic movements (HP:0002487): Motor hyperactivity with excessive movement of muscles of the body as a whole. Evidence: TAS. Frequency: Occasional (HP:0040283). (ORPHA:397933)
- Inappropriate crying (HP:0030215): Uncontrolled episodes of crying occur without any apparent motivating stimuli. Evidence: TAS. Frequency: Occasional (HP:0040283). (ORPHA:397933)
- Self-injurious behavior (HP:0100716): Self-aggression. Evidence: TAS. Frequency: Occasional (HP:0040283). (ORPHA:397933)